- Dystonia (HP:0001332): An abnormally increased muscular tone that causes fixed abnormal postures. There is a slow, intermittent twisting motion that leads to exaggerated turning and posture of the extremities and trunk. Evidence: TAS. Frequency: Very frequent (HP:0040281). (ORPHA:98810)
- Paroxysmal dyskinesia (HP:0007166): Episodic bouts of involuntary movements with dystonic, choreic, ballistic movements, or a combination thereof. There is no loss of consciousness during the attacks. Evidence: TAS. Frequency: Very frequent (HP:0040281). (ORPHA:98810)
- Choreoathetosis (HP:0001266): Involuntary movements characterized by both athetosis (inability to sustain muscles in a fixed position) and chorea (widespread jerky arrhythmic movements). Evidence: TAS. Frequency: Frequent (HP:0040282). (ORPHA:98810)
- Chorea (HP:0002072): Chorea (Greek for 'dance') refers to widespread arrhythmic involuntary movements of a forcible, jerky and restless fashion. It is a random-appearing sequence of one or more discrete involuntary movements or movement fragments. Movements appear random because of variability in timing, duration or location. Each movement may have a distinct start and end. However, movements may be strung together and thus may appear to flow randomly from one muscle group to another. Chorea can involve the trunk, neck, face, tongue, and extremities. Evidence: TAS. Frequency: Frequent (HP:0040282). (ORPHA:98810)
- Hyperkinetic movements (HP:0002487): Motor hyperactivity with excessive movement of muscles of the body as a whole. Evidence: TAS. Frequency: Frequent (HP:0040282). (ORPHA:98810)
- Involuntary movements (HP:0004305): Involuntary contractions of muscle leading to involuntary movements of extremities, neck, trunk, or face. Evidence: TAS. Frequency: Frequent (HP:0040282). (ORPHA:98810)
- Trismus (HP:0000211): Limitation in the ability to open the mouth. Evidence: TAS. Frequency: Occasional (HP:0040283). (ORPHA:98810)
- Torticollis (HP:0000473): Involuntary contractions of the neck musculature resulting in an abnormal posture of or abnormal movements of the head. Evidence: TAS. Frequency: Occasional (HP:0040283). (ORPHA:98810)
- Joint stiffness (HP:0001387): Joint stiffness is a perceived sensation of tightness in a joint or joints when attempting to move them after a period of inactivity. Joint stiffness typically subsides over time. Evidence: TAS. Frequency: Occasional (HP:0040283). (ORPHA:98810)
- Rigidity (HP:0002063): Continuous involuntary sustained muscle contraction. When an affected muscle is passively stretched, the degree of resistance remains constant regardless of the rate at which the muscle is stretched. This feature helps to distinguish rigidity from muscle spasticity. Evidence: TAS. Frequency: Occasional (HP:0040283). (ORPHA:98810)
- Dyspnea (HP:0002094): Difficult or labored breathing. Dyspnea is a subjective feeling only the patient can rate, e.g., on a Borg scale. Evidence: TAS. Frequency: Occasional (HP:0040283). (ORPHA:98810)
- Abnormal speech pattern (HP:0002167): An abnormality in the sound (volume) or cadence (rate) of speech. Evidence: TAS. Frequency: Occasional (HP:0040283). (ORPHA:98810)
- Generalized muscle weakness (HP:0003324): Generalized weakness or decreased strength of the muscles, affecting both distal and proximal musculature. Evidence: TAS. Frequency: Occasional (HP:0040283). (ORPHA:98810)
- Staring gaze (HP:0025401): An abnormality in which the eyes are held permanently wide open. Evidence: TAS. Frequency: Occasional (HP:0040283). (ORPHA:98810)
- Dyskinesia (HP:0100660): A movement disorder which consists of effects including diminished voluntary movements and the presence of involuntary movements. Evidence: TAS. Frequency: Occasional (HP:0040283). (ORPHA:98810)
These phenotypes are associated with the disease Paroxysmal non-kinesigenic dyskinesia (ORPHA:98810).